Phenotypes associated with the disease Post-traumatic pituitary deficiency (ORPHA:95619):
- Hypogonadotropic hypogonadism (HP:0000044): Hypogonadotropic hypogonadism is characterized by reduced function of the gonads (testes in males or ovaries in females) and results from the absence of the gonadal stimulating pituitary hormones: follicle stimulating hormone (FSH) and luteinizing hormone (LH). Evidence: TAS. Frequency: Occasional (HP:0040283). (ORPHA:95619)
- Amenorrhea (HP:0000141): Absence of menses for an interval of time equivalent to a total of more than (or equal to) 3 previous cycles or 6 months. Evidence: TAS. Frequency: Occasional (HP:0040283). (ORPHA:95619)
- Infertility (HP:0000789). Evidence: TAS. Frequency: Occasional (HP:0040283). (ORPHA:95619)
- Decreased response to growth hormone stimulation test (HP:0000824): Insufficient responses to growth hormone (GH) provocation tests. GH deficiency is defined as a serum peak GH concentration less than 10 ng/mL on provocation with a combination of at least two separate stimulation tests. Evidence: TAS. Frequency: Occasional (HP:0040283). (ORPHA:95619)
- Osteopenia (HP:0000938): Osteopenia is a term to define bone density that is not normal but also not as low as osteoporosis. By definition from the World Health Organization osteopenia is defined by bone densitometry as a T score -1 to -2.5. Evidence: TAS. Frequency: Occasional (HP:0040283). (ORPHA:95619)
- Hypoglycemia (HP:0001943): A decreased concentration of glucose in the blood. Evidence: TAS. Frequency: Occasional (HP:0040283). (ORPHA:95619)
- Hypotension (HP:0002615): Low Blood Pressure, vascular hypotension. Evidence: TAS. Frequency: Occasional (HP:0040283). (ORPHA:95619)
- Decreased circulating ACTH concentration (HP:0002920): The concentration of corticotropin, also known as adrenocorticotropic hormone (ACTH), is below the lower limit of normal in the blood circulation. Evidence: TAS. Frequency: Occasional (HP:0040283). (ORPHA:95619)
- Osteoporosis of vertebrae (HP:0005625): Osteoporosis affecting predominantly the vertebrae. Evidence: TAS. Frequency: Occasional (HP:0040283). (ORPHA:95619)
- Fatigue (HP:0012378): A subjective feeling of tiredness characterized by a lack of energy and motivation. Evidence: TAS. Frequency: Occasional (HP:0040283). (ORPHA:95619)
- Abnormal prolactin level (HP:0040086). Evidence: TAS. Frequency: Occasional (HP:0040283). (ORPHA:95619)
- Delayed puberty (HP:0000823): Passing the age when puberty normally occurs with no physical or hormonal signs of the onset of puberty. Evidence: TAS. Frequency: Very rare (HP:0040284). (ORPHA:95619)
- Central diabetes insipidus (HP:0000863): A form of diabetes insipidus related to a failure of vasopressin (AVP) release from the hypothalamus. Evidence: TAS. Frequency: Very rare (HP:0040284). (ORPHA:95619)
- Panhypopituitarism (HP:0000871): A pituitary functional deficit affecting all the anterior pituitary hormones (growth hormone, thyroid-stimulating hormone, follicle-stimulating hormone, luteinizing hormone, adrenocorticotropic hormone, and prolactin). Evidence: TAS. Frequency: Very rare (HP:0040284). (ORPHA:95619)
- Growth delay (HP:0001510): A deficiency or slowing down of growth pre- and postnatally. Evidence: TAS. Frequency: Very rare (HP:0040284). (ORPHA:95619)
- Delayed skeletal maturation (HP:0002750): A decreased rate of skeletal maturation. Delayed skeletal maturation can be diagnosed on the basis of an estimation of the bone age from radiographs of specific bones in the human body. Evidence: TAS. Frequency: Very rare (HP:0040284). (ORPHA:95619)
- Pituitary hypothyroidism (HP:0008245): A type of hypothyroidism that results from a defect in thyroid-stimulating hormone secretion. Evidence: TAS. Frequency: Very rare (HP:0040284). (ORPHA:95619)
- Decreased testicular size (HP:0008734): Reduced volume of the testicle (the male gonad). Evidence: TAS. Frequency: Very rare (HP:0040284). (ORPHA:95619)
- Abnormality of secondary sexual hair (HP:0009888): Abnormality of the growth of secondary sexual hair, which normally ensues during puberty. In males, secondary sexual hair usually comprises body hair, including underarm, abdominal, chest, and pubic hair. In females, secondary sexual hair usually comprises a lesser degree of body hair, most prominently underarm and pubic hair. Evidence: TAS. Frequency: Very rare (HP:0040284). (ORPHA:95619)
- Aplasia/Hypoplasia of the breasts (HP:0010311): Absence or underdevelopment of the breasts. Evidence: TAS. Frequency: Very rare (HP:0040284). (ORPHA:95619)